- Intellectual disability (HP:0001249): The term intellectual disability or intellectual developmental disorder is used to describe significantly sub-average intellectual and adaptive functioning based on clinical assessment and as measured by individually administered, appropriately normed, standardized and validated tests of intellectual functioning and adaptive behavior, with onset during the developmental period from infancy through adolescence. Evidence: IEA. (OMIM:300218)
This phenotype is associated with the disease syndromic X-linked intellectual disability 7 (OMIM:300218).